Phenotypes associated with the disease peeling skin syndrome 4 (OMIM:607936):
- Ichthyosis (HP:0008064): An abnormality of the skin characterized the presence of excessive amounts of dry surface scales on the skin resulting from an abnormality of keratinization. Evidence: IEA. (OMIM:607936)
- Lichenification (HP:0100725): Thickening and hardening of the epidermis seen with exaggeration of normal skin lines. Evidence: TAS. (OMIM:607936)
- Scaling skin (HP:0040189): Refers to the loss of the outer layer of the epidermis in large, scale-like flakes. Evidence: IEA. (OMIM:607936)
- Epidermal acanthosis (HP:0025092): Diffuse hypertrophy or thickening of the stratum spinosum of the epidermis (prickle cell layer of the skin). Evidence: TAS. Frequency: Occasional (HP:0040283). (OMIM:607936)
- Autosomal recessive inheritance (HP:0000007): A mode of inheritance that is observed for traits related to a gene encoded on one of the autosomes (i.e., the human chromosomes 1-22) in which a trait manifests in individuals with two pathogenic alleles, either homozygotes (two copies of the same mutant allele) or compound heterozygotes (whereby each copy of a gene has a distinct mutant allele). Evidence: TAS. (OMIM:607936)
- Orthokeratosis (HP:0040162): Formation of an anuclear keratin layer. Evidence: IEA. (OMIM:607936)
- Nail dystrophy (HP:0008404): Onychodystrophy (nail dystrophy) refers to nail changes apart from changes of the color (nail dyschromia) and involves partial or complete disruption of the various keratinous layers of the nail plate. Evidence: TAS. Frequency: Occasional (HP:0040283). (OMIM:607936)
- Palmoplantar keratoderma (HP:0000982): Abnormal thickening of the skin of the palms of the hands and the soles of the feet. Evidence: TAS. (OMIM:607936)
- Hyperkeratosis (HP:0000962): Hyperkeratosis is a histopathological term defining a thickened stratum corneum and may be present in many different skin conditions, with many possible overlaps. Hyperkeratosis refers to the increased thickness of the stratum corneum, the outer layer of the skin. Hyperkeratosis is subclassified as orthokeratotic or parakeratotic. Orthokeratotic hyperkeratosis refers to the thickening of the keratin layer with preserved keratinocyte maturation, while parakeratotic hyperkeratosis shows retained nuclei as a sign of delayed maturation of keratinocytes. Evidence: TAS. (OMIM:607936)